- Reduced circulating catalase activity (HP:0012517): Activity or concentration of catalase in the blood circulation below the lower limit of normal. Evidence: TAS. Frequency: Very frequent (HP:0040281). (ORPHA:926)
- Oral ulcer (HP:0000155): Erosion of the mucous mebrane of the mouth with local excavation of the surface, resulting from the sloughing of inflammatory necrotic tissue. Evidence: TAS. Frequency: Frequent (HP:0040282). (ORPHA:926)
- Severe periodontitis (HP:0000166): Increased susceptibility to periodontitis, as manifested by severe periodontal infection with rapid alveolar bone loss, tooth mobility, and premature tooth exfoliation. Evidence: TAS. Frequency: Occasional (HP:0040283). (ORPHA:926)
- Gingival bleeding (HP:0000225): Hemorrhage affecting the gingiva. Evidence: TAS. Frequency: Occasional (HP:0040283). (ORPHA:926)
- Gingivitis (HP:0000230): Inflammation of the gingiva. Evidence: TAS. Frequency: Occasional (HP:0040283). (ORPHA:926)
- Microcytic anemia (HP:0001935): A kind of anemia in which the volume of the red blood cells is reduced. Evidence: TAS. Frequency: Occasional (HP:0040283). (ORPHA:926)
- Type II diabetes mellitus (HP:0005978): A type of diabetes mellitus initially characterized by insulin resistance and hyperinsulinemia and subsequently by glucose interolerance and hyperglycemia. Evidence: TAS. Frequency: Occasional (HP:0040283). (ORPHA:926)
- Old-aged sensorineural hearing impairment (HP:0040113). Evidence: TAS. Frequency: Occasional (HP:0040283). (ORPHA:926)
- Gangrene (HP:0100758): A serious and potentially life-threatening condition that arises when a considerable mass of body tissue dies (necrosis). Evidence: TAS. Frequency: Occasional (HP:0040283). (ORPHA:926)
- Vitiligo (HP:0001045). Evidence: TAS. Frequency: Very rare (HP:0040284). (ORPHA:926)
- Parkinsonism (HP:0001300): Characteristic neurologic anomaly resulting from degeneration of dopamine-generating cells in the substantia nigra, a region of the midbrain, characterized clinically by shaking, rigidity, slowness of movement and difficulty with walking and gait. Evidence: TAS. Frequency: Very rare (HP:0040284). (ORPHA:926)
- Arteriosclerosis (HP:0002634): Sclerosis (hardening) of the arteries with increased thickness of the wall of arteries as well as increased stiffness and a loss of elasticity. Evidence: TAS. Frequency: Very rare (HP:0040284). (ORPHA:926)
- Premature loss of permanent teeth (HP:0006357): Premature loss of the permanent teeth. Evidence: TAS. Frequency: Very rare (HP:0040284). (ORPHA:926)
- Pain (HP:0012531): An unpleasant sensory and emotional experience associated with actual or potential tissue damage, or described in terms of such damage. Evidence: TAS. Frequency: Very rare (HP:0040284). (ORPHA:926)
- Neoplasm of the larynx (HP:0100605). Evidence: TAS. Frequency: Very rare (HP:0040284). (ORPHA:926)
- Type I diabetes mellitus (HP:0100651): A chronic condition in which the pancreas produces little or no insulin. Type I diabetes mellitus is manifested by the sudden onset of severe hyperglycemia with rapid progression to diabetic ketoacidosis unless treated with insulin. Evidence: TAS. Frequency: Very rare (HP:0040284). (ORPHA:926)
- Schizophrenia (HP:0100753): A mental disorder characterized by a disintegration of thought processes and emotional responsiveness. It most commonly manifests as auditory hallucinations, paranoid or bizarre delusions, or disorganized speech and thinking. It is accompanied by significant social or occupational dysfunction. The onset of symptoms typically occurs in young adulthood, with a global lifetime prevalence of about 1%. This term is not a helpful parent term to describe abnormal experiences. Evidence: TAS. Frequency: Very rare (HP:0040284). (ORPHA:926)
These phenotypes are associated with the disease Acatalasemia (ORPHA:926).